- Almond-shaped palpebral fissure (HP:0007874, a Human Phenotype Ontology term): A shape created by an acute downward arching of the upper eyelid and upward arching of the lower eyelid, toward the medial canthus, which gives the outline of the palpebral fissures the configuration of an almond. Thus, the maximum distance between the fissures is offset from, and medial to, the center point. Evidence: TAS. Frequency: Frequent (HP:0040282, a Human Phenotype Ontology term). (ORPHA:98793)
- Decreased testicular size (HP:0008734, a Human Phenotype Ontology term): Reduced volume of the testicle (the male gonad). Evidence: TAS. Frequency: Frequent (HP:0040282, a Human Phenotype Ontology term). (ORPHA:98793)
- Obsessive-compulsive trait (HP:0008770, a Human Phenotype Ontology term): The presence of one or more obsessive-compulsive personality traits. Obsessions refer to persistent intrusive thoughts, and compulsions to intrusive behaviors, which the affected person experiences as involuntary, senseless, or repugnant. Evidence: TAS. Frequency: Frequent (HP:0040282, a Human Phenotype Ontology term). (ORPHA:98793)
- Speech articulation difficulties (HP:0009088, a Human Phenotype Ontology term): Impairment in the physical production of speech sounds. Evidence: TAS. Frequency: Frequent (HP:0040282, a Human Phenotype Ontology term). (ORPHA:98793)
- Anterior pituitary hypoplasia (HP:0010627, a Human Phenotype Ontology term): Underdevelopment of the anterior pituitary gland. Evidence: TAS. Frequency: Frequent (HP:0040282, a Human Phenotype Ontology term). (ORPHA:98793)
- Central adrenal insufficiency (HP:0011734, a Human Phenotype Ontology term): A form of adrenal insufficiency related to a lack of ACTH, which leads to a decrease in the production of cortisol by the adrenal glands. Aldosterone production is not usually affected. Evidence: TAS. Frequency: Frequent (HP:0040282, a Human Phenotype Ontology term). (ORPHA:98793)
- Central hypothyroidism (HP:0011787, a Human Phenotype Ontology term): A type of hypothyroidism due to an insufficient stimulation of an otherwise normal thyroid gland. Central hypothyroidism is caused by either pituitary (secondary hypothyroidism) or hypothalamic (tertiary hypothyroidism) defects. Evidence: TAS. Frequency: Frequent (HP:0040282, a Human Phenotype Ontology term). (ORPHA:98793)
- Parietal cortical atrophy (HP:0012104, a Human Phenotype Ontology term): Atrophy of the parietal cortex. Evidence: TAS. Frequency: Frequent (HP:0040282, a Human Phenotype Ontology term). (ORPHA:98793)
- Occipital cortical atrophy (HP:0012105, a Human Phenotype Ontology term): Atrophy of the occipital cortex. Evidence: TAS. Frequency: Frequent (HP:0040282, a Human Phenotype Ontology term). (ORPHA:98793)
- Skin-picking (HP:0012166, a Human Phenotype Ontology term): Repetitive and compulsive picking of skin which results in tissue damage. Evidence: TAS. Frequency: Frequent (HP:0040282, a Human Phenotype Ontology term). (ORPHA:98793)
- Premature pubarche (HP:0012411, a Human Phenotype Ontology term): The onset of growth of pubic hair at an earlier age than normal. Evidence: TAS. Frequency: Frequent (HP:0040282, a Human Phenotype Ontology term). (ORPHA:98793)
- Premature adrenarche (HP:0012412, a Human Phenotype Ontology term): Onset of adrenarche at an earlier age than usual. Evidence: TAS. Frequency: Frequent (HP:0040282, a Human Phenotype Ontology term). (ORPHA:98793)
- Perisylvian polymicrogyria (HP:0012650, a Human Phenotype Ontology term): Polymicrogyria (an excessive number of small gyri or convolutions) that is maximal in perisylvian regions (the regions that surround the Sylvian fissures), which may be symmetric or asymmetric and may extend beyond perisylvian regions. The Sylvian fissures often extend posteriorly and superiorly. Evidence: TAS. Frequency: Frequent (HP:0040282, a Human Phenotype Ontology term). (ORPHA:98793)
- Abnormal temper tantrums (HP:0025160, a Human Phenotype Ontology term): Temper tantrums are brief episodes of extreme, unpleasant, and sometimes aggressive behaviors in response to frustration or anger, which are a normal part of development in toddlers. Temper tantrums that occur more frequently in a given time and/or are more severe in symptomatology and/or longer in duration and/or inappropriate for the given age compared to a temper tantrum that naturally occurs as a part of the developmental process are classified as abnormal temper tantrums. Evidence: TAS. Frequency: Frequent (HP:0040282, a Human Phenotype Ontology term). (ORPHA:98793)
- Decreased circulating gonadotropin concentration (HP:0030339, a Human Phenotype Ontology term): A reduction of the circulating level of a gonadotropin, that is, of a protein hormone secreted by gonadotrope cells of the anterior pituitary of vertebrates. The primary gonadotropins are luteinizing hormone (LH) and follicle-stimulating hormone (FSH). Evidence: TAS. Frequency: Frequent (HP:0040282, a Human Phenotype Ontology term). (ORPHA:98793)
- Decreased circulating T4 concentration (HP:0031507, a Human Phenotype Ontology term): A reduction below the normal concentration of thyroxine in the blood. Thyroxine (also known as T4) is the main hormone secreted by the thyroid gland into the blood. It can be converted into the active form triiodothyronine (also known as T3). Evidence: TAS. Frequency: Frequent (HP:0040282, a Human Phenotype Ontology term). (ORPHA:98793)
- Self-injurious behavior (HP:0100716, a Human Phenotype Ontology term): Self-aggression. Evidence: TAS. Frequency: Frequent (HP:0040282, a Human Phenotype Ontology term). (ORPHA:98793)
- Bulimia (HP:0100739, a Human Phenotype Ontology term): A form of anomalous eating behavior characterized by binge eating is followed by self-induced vomiting or other compensatory behavior intended to prevent weight gain (purging, fasting or exercising or a combination of these). Evidence: TAS. Frequency: Frequent (HP:0040282, a Human Phenotype Ontology term). (ORPHA:98793)
- Small hand (HP:0200055, a Human Phenotype Ontology term): Disproportionately small hand. Evidence: TAS. Frequency: Frequent (HP:0040282, a Human Phenotype Ontology term). (ORPHA:98793)
- Osteopenia (HP:0000938, a Human Phenotype Ontology term): Osteopenia is a term to define bone density that is not normal but also not as low as osteoporosis. By definition from the World Health Organization osteopenia is defined by bone densitometry as a T score -1 to -2.5. Evidence: TAS. Frequency: Occasional (HP:0040283, a Human Phenotype Ontology term). (ORPHA:98793)
- Cryptorchidism (HP:0000028, a Human Phenotype Ontology term): Testis in inguinal canal. That is, absence of one or both testes from the scrotum owing to failure of the testis or testes to descend through the inguinal canal to the scrotum. Evidence: TAS. Frequency: Very frequent (HP:0040281, a Human Phenotype Ontology term). (ORPHA:98793)
- Obesity (HP:0001513, a Human Phenotype Ontology term): Accumulation of substantial excess body fat. Evidence: TAS. Frequency: Very frequent (HP:0040281, a Human Phenotype Ontology term). (ORPHA:98793)
- Ventriculomegaly (HP:0002119, a Human Phenotype Ontology term): An increase in size of the ventricular system of the brain. Evidence: TAS. Frequency: Very frequent (HP:0040281, a Human Phenotype Ontology term). (ORPHA:98793)
- Feeding difficulties in infancy (HP:0008872, a Human Phenotype Ontology term): Impaired feeding performance of an infant as manifested by difficulties such as weak and ineffective sucking, brief bursts of sucking, and falling asleep during sucking. There may be difficulties with chewing or maintaining attention. Evidence: TAS. Frequency: Very frequent (HP:0040281, a Human Phenotype Ontology term). (ORPHA:98793)
- Hypogonadotropic hypogonadism (HP:0000044, a Human Phenotype Ontology term): Hypogonadotropic hypogonadism is characterized by reduced function of the gonads (testes in males or ovaries in females) and results from the absence of the gonadal stimulating pituitary hormones: follicle stimulating hormone (FSH) and luteinizing hormone (LH). Evidence: TAS. Frequency: Frequent (HP:0040282, a Human Phenotype Ontology term). (ORPHA:98793)
- Small scrotum (HP:0000046, a Human Phenotype Ontology term): Apparently small scrotum for age. Evidence: TAS. Frequency: Frequent (HP:0040282, a Human Phenotype Ontology term). (ORPHA:98793)
- Clitoral hypoplasia (HP:0000060, a Human Phenotype Ontology term): Developmental hypoplasia of the clitoris. Evidence: TAS. Frequency: Frequent (HP:0040282, a Human Phenotype Ontology term). (ORPHA:98793)
- Hypoplastic labia minora (HP:0000064, a Human Phenotype Ontology term). Evidence: TAS. Frequency: Frequent (HP:0040282, a Human Phenotype Ontology term). (ORPHA:98793)
- Strabismus (HP:0000486, a Human Phenotype Ontology term): A misalignment of the eyes so that the visual axes deviate from bifoveal fixation. The classification of strabismus may be based on a number of features including the relative position of the eyes, whether the deviation is latent or manifest, intermittent or constant, concomitant or otherwise and according to the age of onset and the relevance of any associated refractive error. Evidence: TAS. Frequency: Frequent (HP:0040282, a Human Phenotype Ontology term). (ORPHA:98793)
- Abnormality of vision (HP:0000504, a Human Phenotype Ontology term): Abnormality of eyesight (visual perception). Evidence: TAS. Frequency: Frequent (HP:0040282, a Human Phenotype Ontology term). (ORPHA:98793)
- Atypical behavior (HP:0000708, a Human Phenotype Ontology term): Atypical behavior is an abnormality in a person's actions that can be controlled or modulated by the will of the individual. While abnormal behaviors can be difficult to control, they are distinct from other abnormal actions that cannot be affected by the individual's will. Evidence: TAS. Frequency: Frequent (HP:0040282, a Human Phenotype Ontology term). (ORPHA:98793)
- Psychosis (HP:0000709, a Human Phenotype Ontology term): A condition characterized by changes in personality and thought patterns, often accompanied by hallucinations and delusional beliefs, is known as psychosis. Evidence: TAS. Frequency: Frequent (HP:0040282, a Human Phenotype Ontology term). (ORPHA:98793)
- Autism (HP:0000717, a Human Phenotype Ontology term): Autism is a neurodevelopmental disorder characterized by impaired social interaction and communication, and by restricted and repetitive behavior. Autism begins in childhood. It is marked by the presence of markedly abnormal or impaired development in social interaction and communication and a markedly restricted repertoire of activity and interest. Manifestations of the disorder vary greatly depending on the developmental level and chronological age of the individual (DSM-IV). Evidence: TAS. Frequency: Frequent (HP:0040282, a Human Phenotype Ontology term). (ORPHA:98793)
- Autistic behavior (HP:0000729, a Human Phenotype Ontology term): Persistent deficits in social interaction and communication and interaction as well as a markedly restricted repertoire of activity and interest as well as repetitive patterns of behavior. Evidence: TAS. Frequency: Frequent (HP:0040282, a Human Phenotype Ontology term). (ORPHA:98793)
- Primary amenorrhea (HP:0000786, a Human Phenotype Ontology term). Evidence: TAS. Frequency: Frequent (HP:0040282, a Human Phenotype Ontology term). (ORPHA:98793)
- Infertility (HP:0000789, a Human Phenotype Ontology term). Evidence: TAS. Frequency: Frequent (HP:0040282, a Human Phenotype Ontology term). (ORPHA:98793)
- Diabetes mellitus (HP:0000819, a Human Phenotype Ontology term): A group of abnormalities characterized by hyperglycemia and glucose intolerance. Evidence: TAS. Frequency: Frequent (HP:0040282, a Human Phenotype Ontology term). (ORPHA:98793)
- Delayed puberty (HP:0000823, a Human Phenotype Ontology term): Passing the age when puberty normally occurs with no physical or hormonal signs of the onset of puberty. Evidence: TAS. Frequency: Frequent (HP:0040282, a Human Phenotype Ontology term). (ORPHA:98793)
- Decreased response to growth hormone stimulation test (HP:0000824, a Human Phenotype Ontology term): Insufficient responses to growth hormone (GH) provocation tests. GH deficiency is defined as a serum peak GH concentration less than 10 ng/mL on provocation with a combination of at least two separate stimulation tests. Evidence: TAS. Frequency: Frequent (HP:0040282, a Human Phenotype Ontology term). (ORPHA:98793)
- Hypopigmentation of the skin (HP:0001010, a Human Phenotype Ontology term): A reduction of skin color related to a decrease in melanin production and deposition. Evidence: TAS. Frequency: Frequent (HP:0040282, a Human Phenotype Ontology term). (ORPHA:98793)
- Hypotonia (HP:0001252, a Human Phenotype Ontology term): Hypotonia is an abnormally low muscle tone (the amount of tension or resistance to movement in a muscle). Even when relaxed, muscles have a continuous and passive partial contraction which provides some resistance to passive stretching. Hypotonia thus manifests as diminished resistance to passive stretching. Hypotonia is not the same as muscle weakness, although the two conditions can co-exist. Evidence: TAS. Frequency: Frequent (HP:0040282, a Human Phenotype Ontology term). (ORPHA:98793)
- Global developmental delay (HP:0001263, a Human Phenotype Ontology term): A delay in the achievement of motor or mental milestones in the domains of development of a child, including motor skills, speech and language, cognitive skills, and social and emotional skills. This term should only be used to describe children younger than five years of age. Evidence: TAS. Frequency: Frequent (HP:0040282, a Human Phenotype Ontology term). (ORPHA:98793)
- Specific learning disability (HP:0001328, a Human Phenotype Ontology term): Impairment of certain skills such as reading or writing, coordination, self-control, or attention that interfere with the ability to learn. The impairment is not related to a global deficiency of intelligence. Evidence: TAS. Frequency: Frequent (HP:0040282, a Human Phenotype Ontology term). (ORPHA:98793)
- Failure to thrive (HP:0001508, a Human Phenotype Ontology term): Failure to thrive (FTT) refers to a child whose physical growth is substantially below the norm. Evidence: TAS. Frequency: Frequent (HP:0040282, a Human Phenotype Ontology term). (ORPHA:98793)
- Short foot (HP:0001773, a Human Phenotype Ontology term): A measured foot length that is more than 2 SD below the mean for a newborn of 27 - 41 weeks gestation, or foot that is less than the 3rd centile for individuals from birth to 16 years of age (objective). Alternatively, a foot that appears disproportionately short (subjective). Evidence: TAS. Frequency: Frequent (HP:0040282, a Human Phenotype Ontology term). (ORPHA:98793)
- Recurrent respiratory infections (HP:0002205, a Human Phenotype Ontology term): An increased susceptibility to respiratory infections as manifested by a history of recurrent respiratory infections. Evidence: TAS. Frequency: Frequent (HP:0040282, a Human Phenotype Ontology term). (ORPHA:98793)
- Moderate intellectual disability (HP:0002342, a Human Phenotype Ontology term): Moderate intellectual disability (ID) is defined as a type of ID characterized by moderately sub-average adaptive functioning and intellectual functioning, with an intelligence quotient (IQ) the range of 35-49. Evidence: TAS. Frequency: Frequent (HP:0040282, a Human Phenotype Ontology term). (ORPHA:98793)
- Sleep disturbance (HP:0002360, a Human Phenotype Ontology term): An abnormal pattern in the quality, quantity, or characteristics of sleep. Evidence: TAS. Frequency: Frequent (HP:0040282, a Human Phenotype Ontology term). (ORPHA:98793)
- Polyphagia (HP:0002591, a Human Phenotype Ontology term): A neurological anomaly with gross overeating associated with an abnormally strong desire or need to eat. Evidence: TAS. Frequency: Frequent (HP:0040282, a Human Phenotype Ontology term). (ORPHA:98793)
- Scoliosis (HP:0002650, a Human Phenotype Ontology term): The presence of an abnormal lateral curvature of the spine. Evidence: TAS. Frequency: Frequent (HP:0040282, a Human Phenotype Ontology term). (ORPHA:98793)
- External genital hypoplasia (HP:0003241, a Human Phenotype Ontology term): Underdevelopment of part or all of the external reproductive organs. Evidence: TAS. Frequency: Frequent (HP:0040282, a Human Phenotype Ontology term). (ORPHA:98793)
- Short stature (HP:0004322, a Human Phenotype Ontology term): A height below that which is expected according to age and gender norms. Although there is no universally accepted definition of short stature, many refer to "short stature" as height more than 2 standard deviations below the mean for age and gender (or below the 3rd percentile for age and gender dependent norms). Evidence: TAS. Frequency: Frequent (HP:0040282, a Human Phenotype Ontology term). (ORPHA:98793)
- Hypopigmentation of hair (HP:0005599, a Human Phenotype Ontology term). Evidence: TAS. Frequency: Frequent (HP:0040282, a Human Phenotype Ontology term). (ORPHA:98793)
- Iris hypopigmentation (HP:0007730, a Human Phenotype Ontology term): An abnormal reduction in the amount of pigmentation of the iris. Evidence: TAS. Frequency: Frequent (HP:0040282, a Human Phenotype Ontology term). (ORPHA:98793)
- Osteoporosis (HP:0000939, a Human Phenotype Ontology term): Osteoporosis is a systemic skeletal disease characterized by low bone density and microarchitectural deterioration of bone tissue with a consequent increase in bone fragility. According to the WHO criteria, osteoporosis is defined as a BMD that lies 2.5 standard deviations or more below the average value for young healthy adults (a T-score below -2.5 SD). Evidence: TAS. Frequency: Occasional (HP:0040283, a Human Phenotype Ontology term). (ORPHA:98793)
- Seizure (HP:0001250, a Human Phenotype Ontology term): A seizure is an intermittent abnormality of nervous system physiology characterized by a transient occurrence of signs and/or symptoms due to abnormal excessive or synchronous neuronal activity in the brain. Evidence: TAS. Frequency: Occasional (HP:0040283, a Human Phenotype Ontology term). (ORPHA:98793)
- Mild intellectual disability (HP:0001256, a Human Phenotype Ontology term): Mild intellectual disability (ID) is defined as a type of ID characterized by mildly sub-average adaptive functioning and intellectual functioning, with an intelligence quotient (IQ) the range of 50-69. Evidence: TAS. Frequency: Occasional (HP:0040283, a Human Phenotype Ontology term). (ORPHA:98793)
- Hip dysplasia (HP:0001385, a Human Phenotype Ontology term): The presence of developmental dysplasia of the hip. Evidence: TAS. Frequency: Occasional (HP:0040283, a Human Phenotype Ontology term). (ORPHA:98793)
- Small for gestational age (HP:0001518, a Human Phenotype Ontology term): Smaller than normal size according to sex and gestational age related norms, defined as a weight below the 10th percentile for the gestational age. Evidence: TAS. Frequency: Occasional (HP:0040283, a Human Phenotype Ontology term). (ORPHA:98793)
- Decreased fetal movement (HP:0001558, a Human Phenotype Ontology term): An abnormal reduction in quantity or strength of fetal movements. Evidence: TAS. Frequency: Occasional (HP:0040283, a Human Phenotype Ontology term). (ORPHA:98793)
- Gastroparesis (HP:0002578, a Human Phenotype Ontology term): Decreased strength of the muscle layer of stomach, which leads to a decreased ability to empty the contents of the stomach despite the absence of obstruction. Evidence: TAS. Frequency: Occasional (HP:0040283, a Human Phenotype Ontology term). (ORPHA:98793)
- Downturned corners of mouth (HP:0002714, a Human Phenotype Ontology term): A morphological abnormality of the mouth in which the angle of the mouth is downturned. The oral commissures are positioned inferior to the midline labial fissure. Evidence: TAS. Frequency: Occasional (HP:0040283, a Human Phenotype Ontology term). (ORPHA:98793)
- Obstructive sleep apnea (HP:0002870, a Human Phenotype Ontology term): Obstructive Sleep Apnea is a condition characterized by the obstruction of the airway and pauses in breathing during sleep, which occur multiple times throughout the night. It is related to the relaxation of muscle tone that typically happens during sleep, leading to a partial collapse of the soft tissues in the airway and causing airflow obstruction. Evidence: TAS. Frequency: Occasional (HP:0040283, a Human Phenotype Ontology term). (ORPHA:98793)
- Central apnea (HP:0002871, a Human Phenotype Ontology term): Apnea resulting from depression of the respiratory centers in the medulla oblongata. There is a lack of respiratory effort rather than obstruction of airflow. Evidence: TAS. Frequency: Occasional (HP:0040283, a Human Phenotype Ontology term). (ORPHA:98793)
- Borderline intellectual disability (HP:0006889, a Human Phenotype Ontology term): Borderline intellectual disability is defined as an intelligence quotient (IQ) in the range of 70-85. Evidence: TAS. Frequency: Occasional (HP:0040283, a Human Phenotype Ontology term). (ORPHA:98793)
- Pedal edema (HP:0010741, a Human Phenotype Ontology term): An abnormal accumulation of excess fluid in the lower extremity resulting in swelling of the feet and extending upward to the lower leg. Evidence: TAS. Frequency: Occasional (HP:0040283, a Human Phenotype Ontology term). (ORPHA:98793)
- Impaired temperature sensation (HP:0010829, a Human Phenotype Ontology term): A reduced ability to discriminate between different temperatures. Evidence: TAS. Frequency: Occasional (HP:0040283, a Human Phenotype Ontology term). (ORPHA:98793)
- Decreased circulating inhibin B concentration (HP:0031100, a Human Phenotype Ontology term): The concentration of inhibin B in the blood circulation is below the lower limit of normal. Evidence: TAS. Frequency: Occasional (HP:0040283, a Human Phenotype Ontology term). (ORPHA:98793)
- Postterm pregnancy (HP:0031169, a Human Phenotype Ontology term): A pregnancy that extends to 42 weeks of gestation or beyond. Evidence: TAS. Frequency: Occasional (HP:0040283, a Human Phenotype Ontology term). (ORPHA:98793)
- Precocious puberty (HP:0000826, a Human Phenotype Ontology term): The onset of secondary sexual characteristics before a normal age. Although it is difficult to define normal age ranges because of the marked variation with which puberty begins in normal children, precocious puberty can be defined as the onset of puberty before the age of 8 years in girls or 9 years in boys. Evidence: TAS. Frequency: Very rare (HP:0040284, a Human Phenotype Ontology term). (ORPHA:98793)
These phenotypes are associated with the disease Prader-Willi syndrome due to paternal 15q11q13 deletion (ORPHA:98793, an Orphanet rare-disease identifier).